- Cleft palate (HP:0000175): Cleft palate is a developmental defect of the palate resulting from a failure of fusion of the palatine processes and manifesting as a separation of the roof of the mouth (soft and hard palate). Evidence: IEA. (OMIM:168500)
- Parietal foramina (HP:0002697): The presence of symmetrical and circular openings (foramina) in the parietal bone ranging in size from a few millimeters to several centimeters wide. Evidence: PCS. Frequency: 19/20. (OMIM:168500;PMID:10742103)
- Seizure (HP:0001250): A seizure is an intermittent abnormality of nervous system physiology characterized by a transient occurrence of signs and/or symptoms due to abnormal excessive or synchronous neuronal activity in the brain. Evidence: IEA. (OMIM:168500)
- Aplasia cutis congenita of scalp (HP:0007385): A developmental defect resulting in the congenital absence of skin on the scalp. Evidence: IEA. (OMIM:168500)
- Blue sclerae (HP:0000592): An abnormal bluish coloration of the sclera. Evidence: PCS. Frequency: 1/10. (PMID:10742103)
- Encephalocele (HP:0002084): A neural tube defect characterized by sac-like protrusions of the brain and the membranes that cover it through openings in the skull. Evidence: IEA. (OMIM:168500)
- Headache (HP:0002315): Cephalgia, or pain sensed in various parts of the head, not confined to the area of distribution of any nerve. Evidence: IEA. (OMIM:168500)
- Wormian bones (HP:0002645): The presence of extra bones within a cranial suture. Wormian bones are irregular isolated bones which appear in addition to the usual centers of ossification of the cranium. Evidence: PCS. Frequency: 1/10. (PMID:10742103)
- Macrocephaly (HP:0000256): Occipitofrontal (head) circumference greater than 97th centile compared to appropriate, age matched, sex-matched normal standards. Alternatively, a apparently increased size of the cranium. Evidence: PCS. Frequency: 1/10. (PMID:10742103)
- Autosomal dominant inheritance (HP:0000006): A mode of inheritance that is observed for traits related to a gene encoded on one of the autosomes (i.e., the human chromosomes 1-22) in which a trait manifests in heterozygotes. In the context of medical genetics, an autosomal dominant disorder is caused when a single copy of the mutant allele is present. Males and females are affected equally, and can both transmit the disorder with a risk of 50% for each child of inheriting the mutant allele. Evidence: PCS. (PMID:10742103)
- Cleft upper lip (HP:0000204): A gap or groove in the upper lip. This is a congenital defect resulting from nonfusion of tissues of the lip during embryonal development. Evidence: IEA. (OMIM:168500)
These phenotypes are associated with the disease parietal foramina 1 (OMIM:168500).